Phenotypes associated with the disease combined oxidative phosphorylation deficiency 43 (OMIM:618851):
- Projectile vomiting (HP:0002587): Vomiting that ejects the gastric contents with great force. Evidence: PCS. Frequency: 1/1. (PMID:30452684)
- Elevated circulating creatine kinase activity (HP:0003236): The activity of creatine kinase in the blood circulation is above the upper limit of normal. Evidence: PCS. Frequency: 1/1. (PMID:30452684)
- Delayed CNS myelination (HP:0002188): Delayed myelination in the central nervous system. Evidence: PCS. Frequency: 1/1. (PMID:30452684)
- Decreased activity of mitochondrial complex III (HP:0011924): A reduction in the activity of the mitochondrial respiratory chain complex III, which is part of the electron transport chain in mitochondria. Evidence: PCS. Frequency: 1/1. (PMID:30452684)
- Acetabular dysplasia (HP:0008807): A smaller than normal acetabulum that has insufficient femoral head coverage leading to abnormal hip joint contact pressures, instability and pain. Evidence: PCS. Frequency: 1/1. (PMID:30452684)
- Increased circulating lactate concentration (HP:0002151): Abnormally increased level of blood lactate (2-hydroxypropanoic acid). Lactate is produced from pyruvate by lactate dehydrogenase during normal metabolism. The terms lactate and lactic acid are often used interchangeably but lactate (the component measured in blood) is strictly a weak base whereas lactic acid is the corresponding acid. Lactic acidosis is often used clinically to describe elevated lactate but should be reserved for cases where there is a corresponding acidosis (pH below 7.35). Evidence: PCS. Frequency: 1/1. (PMID:30452684)
- Gastroesophageal reflux (HP:0002020): A condition in which the stomach contents leak backwards from the stomach into the esophagus through the lower esophageal sphincter. Evidence: PCS. Frequency: 1/1. (PMID:30452684)
- Decreased activity of mitochondrial complex I (HP:0011923): A reduction in the activity of the mitochondrial respiratory chain complex I, which is part of the electron transport chain in mitochondria. Evidence: PCS. Frequency: 1/1. (PMID:30452684)
- Small for gestational age (HP:0001518): Smaller than normal size according to sex and gestational age related norms, defined as a weight below the 10th percentile for the gestational age. Evidence: PCS. Frequency: 1/1. (PMID:30452684)
- Autosomal recessive inheritance (HP:0000007): A mode of inheritance that is observed for traits related to a gene encoded on one of the autosomes (i.e., the human chromosomes 1-22) in which a trait manifests in individuals with two pathogenic alleles, either homozygotes (two copies of the same mutant allele) or compound heterozygotes (whereby each copy of a gene has a distinct mutant allele). Evidence: PCS. (PMID:30452684)
- Feeding difficulties in infancy (HP:0008872): Impaired feeding performance of an infant as manifested by difficulties such as weak and ineffective sucking, brief bursts of sucking, and falling asleep during sucking. There may be difficulties with chewing or maintaining attention. Evidence: PCS. Frequency: 1/1. Onset: Infantile onset (HP:0003593). (PMID:30452684)
- Neonatal hypotonia (HP:0001319): Muscular hypotonia (abnormally low muscle tone) manifesting in the neonatal period. Evidence: PCS. Frequency: 1/1. Onset: Neonatal onset (HP:0003623). (PMID:30452684)
- Decreased activity of mitochondrial complex IV (HP:0008347): A reduction in the activity of the mitochondrial respiratory chain complex IV, which is part of the electron transport chain in mitochondria. Evidence: PCS. Frequency: 1/1. (PMID:30452684)
- Intrauterine growth retardation (HP:0001511): An abnormal restriction of fetal growth with fetal weight below the tenth percentile for gestational age. Evidence: PCS. Frequency: 1/1. (PMID:30452684)